Phenotypes associated with the disease Li-Campeau syndrome (OMIM:619189):
- Congenital onset (HP:0003577): A phenotypic abnormality that is present at birth. Evidence: PCS. (PMID:33340455)
- Long philtrum (HP:0000343): Distance between nasal base and midline upper lip vermilion border more than 2 SD above the mean. Alternatively, an apparently increased distance between nasal base and midline upper lip vermilion border. Evidence: PCS. Frequency: 2/7. (PMID:33340455)
- Short stature (HP:0004322): A height below that which is expected according to age and gender norms. Although there is no universally accepted definition of short stature, many refer to "short stature" as height more than 2 standard deviations below the mean for age and gender (or below the 3rd percentile for age and gender dependent norms). Evidence: PCS. Frequency: 5/7. (PMID:33340455)
- Seizure (HP:0001250): A seizure is an intermittent abnormality of nervous system physiology characterized by a transient occurrence of signs and/or symptoms due to abnormal excessive or synchronous neuronal activity in the brain. Evidence: PCS. Frequency: 6/7. (PMID:33340455)
- Hypotonia (HP:0001252): Hypotonia is an abnormally low muscle tone (the amount of tension or resistance to movement in a muscle). Even when relaxed, muscles have a continuous and passive partial contraction which provides some resistance to passive stretching. Hypotonia thus manifests as diminished resistance to passive stretching. Hypotonia is not the same as muscle weakness, although the two conditions can co-exist. Evidence: PCS. Frequency: 6/7. (PMID:33340455)
- Ventricular septal defect (HP:0001629): A hole between the two bottom chambers (ventricles) of the heart. The defect is centered around the most superior aspect of the ventricular septum. Evidence: PCS. Frequency: 2/7. Onset: Congenital onset (HP:0003577). (PMID:33340455)
- Prominent forehead (HP:0011220): Forward prominence of the entire forehead, due to protrusion of the frontal bone. Evidence: PCS. Frequency: 3/7. (PMID:33340455)
- Hypertelorism (HP:0000316): Interpupillary distance more than 2 SD above the mean (alternatively, the appearance of an increased interpupillary distance or widely spaced eyes). Evidence: PCS. Frequency: 4/7. (PMID:33340455)
- Single transverse palmar crease (HP:0000954): The distal and proximal transverse palmar creases are merged into a single transverse palmar crease. Evidence: PCS. Frequency: 1/7. (PMID:33340455)
- Hypertrichosis (HP:0000998): Hypertrichosis is increased hair growth that is abnormal in quantity or location. Evidence: PCS. Frequency: 1/7. (PMID:33340455)
- Patent ductus arteriosus (HP:0001643): In utero, the ductus arteriosus (DA) serves to divert ventricular output away from the lungs and toward the placenta by connecting the main pulmonary artery to the descending aorta. A patent ductus arteriosus (PDA) in the first 3 days of life is a physiologic shunt in healthy term and preterm newborn infants, and normally is substantially closed within about 24 hours after bith and completely closed after about three weeks. Failure of physiologcal closure is referred to a persistent or patent ductus arteriosus (PDA). Depending on the degree of left-to-right shunting, PDA can have clinical consequences. Evidence: PCS. Frequency: 2/7. Onset: Neonatal onset (HP:0003623). (PMID:33340455)
- Gastrointestinal dysmotility (HP:0002579): Abnormal intestinal contractions, such as spasms and intestinal paralysis, related to the loss of the ability of the gut to coordinate muscular activity because of endogenous or exogenous causes. Evidence: PCS. Frequency: 1/7. (PMID:33340455)
- Intellectual disability (HP:0001249): The term intellectual disability or intellectual developmental disorder is used to describe significantly sub-average intellectual and adaptive functioning based on clinical assessment and as measured by individually administered, appropriately normed, standardized and validated tests of intellectual functioning and adaptive behavior, with onset during the developmental period from infancy through adolescence. Evidence: PCS. Frequency: 7/7. (PMID:33340455)
- Micropenis (HP:0000054): Abnormally small penis. At birth, the normal penis is about 3 cm (stretched length from pubic tubercle to tip of penis) with micropenis less than 2.0-2.5 cm. Evidence: PCS. Frequency: 1/6. (PMID:33340455)
- Downslanted palpebral fissures (HP:0000494): The palpebral fissure inclination is more than two standard deviations below the mean. Evidence: PCS. Frequency: 3/7. (PMID:33340455)
- Thick eyebrow (HP:0000574): Increased density/number and/or increased diameter of eyebrow hairs. Evidence: PCS. Frequency: 1/7. (PMID:33340455)
- Global developmental delay (HP:0001263): A delay in the achievement of motor or mental milestones in the domains of development of a child, including motor skills, speech and language, cognitive skills, and social and emotional skills. This term should only be used to describe children younger than five years of age. Evidence: PCS. Frequency: 7/7. (PMID:33340455)
- Patellar hypoplasia (HP:0003065): Underdevelopment of the patella. Evidence: PCS. Frequency: 1/7. (PMID:33340455)
- Sudden unexpected death in epilepsy (HP:0033258): Sudden unexpected death in epilepsy (SUDEP) is a sudden, unexpected, witnessed or unwitnessed, non-traumatic and non-drowning death, occurring in benign circumstances, in an individual with epilepsy, with or without evidence for a seizure and excluding documented status epilepticus, in which postmortem examination has not revealed a cause of death. Evidence: PCS. Frequency: 1/7. Onset: Childhood onset (HP:0011463). (PMID:33340455)
- Telecanthus (HP:0000506): Distance between the inner canthi more than two standard deviations above the mean (objective); or, apparently increased distance between the inner canthi. Evidence: PCS. Frequency: 1/7. (PMID:33340455)
- Ptosis (HP:0000508): The upper eyelid margin is positioned 3 mm or more lower than usual and covers the superior portion of the iris (objective); or, the upper lid margin obscures at least part of the pupil (subjective). Evidence: PCS. Frequency: 5/7. (PMID:33340455)
- Autosomal recessive inheritance (HP:0000007): A mode of inheritance that is observed for traits related to a gene encoded on one of the autosomes (i.e., the human chromosomes 1-22) in which a trait manifests in individuals with two pathogenic alleles, either homozygotes (two copies of the same mutant allele) or compound heterozygotes (whereby each copy of a gene has a distinct mutant allele). Evidence: PCS. (PMID:33340455)
- Hypothyroidism (HP:0000821): Deficiency of thyroid hormone. Evidence: PCS. Frequency: 4/7. (PMID:33340455)
- Atrial septal defect (HP:0001631): Atrial septal defect (ASD) is a congenital abnormality of the interatrial septum that enables blood flow between the left and right atria via the interatrial septum. Evidence: PCS. Frequency: 1/7. (PMID:33340455)
- Cryptorchidism (HP:0000028): Testis in inguinal canal. That is, absence of one or both testes from the scrotum owing to failure of the testis or testes to descend through the inguinal canal to the scrotum. Evidence: PCS. Frequency: 5/6. (PMID:33340455)
- Low-set ears (HP:0000369): Upper insertion of the ear to the scalp below an imaginary horizontal line drawn between the inner canthi of the eye and extending posteriorly to the ear. Evidence: PCS. Frequency: 3/7. (PMID:33340455)
- Patent foramen ovale (HP:0001655): Failure of the foramen ovale to seal postnatally, leaving a potential conduit between the left and right cardiac atria. Evidence: PCS. Frequency: 1/7. Onset: Neonatal onset (HP:0003623). (PMID:33340455)